Phenotypes associated with the disease Rapidly involuting congenital hemangioma (ORPHA:141184):
- Hemangioma (HP:0001028): A hemangioma is a benign tumor characterized by blood-filled spaces lined by benign endothelial cells. A hemangioma characterized by large endothelial spaces (caverns) is called a cavernous hemangioma (in contrast to a hemangioma with small endothelial spaces, which is called capillary hemangioma). Evidence: TAS. Frequency: Obligate (HP:0040280). (ORPHA:141184)
- Midfrontal capillary hemangioma (HP:0007466). Evidence: TAS. Frequency: Frequent (HP:0040282). (ORPHA:141184)
- Subcutaneous calcification (HP:0007618): Deposition of calcium salts in subcutaneous tissue (i.e., the the lowermost layer of the integument). Evidence: TAS. Frequency: Frequent (HP:0040282). (ORPHA:141184)
- Perineal hemangioma (HP:0031449): Hemangioma, a benign tumor of the vascular endothelial cells, located in the perineal region, i.e., the region between the anus and the genitals. Evidence: TAS. Frequency: Frequent (HP:0040282). (ORPHA:141184)
- Telangiectasia of the skin (HP:0100585): Presence of small, permanently dilated blood vessels near the surface of the skin, visible as small focal red lesions. Evidence: TAS. Frequency: Frequent (HP:0040282). (ORPHA:141184)
- Prominent superficial veins (HP:0001015): A condition in which superficial veins (i.e., veins just under the skin) are more conspicuous or noticeable than normal. Evidence: TAS. Frequency: Occasional (HP:0040283). (ORPHA:141184)
- Congestive heart failure (HP:0001635): The presence of an abnormality of cardiac function that is responsible for the failure of the heart to pump blood at a rate that is commensurate with the needs of the tissues or a state in which abnormally elevated filling pressures are required for the heart to do so. Heart failure is frequently related to a defect in myocardial contraction. Evidence: TAS. Frequency: Occasional (HP:0040283). (ORPHA:141184)
- Thrombocytopenia (HP:0001873): A reduction in the number of circulating thrombocytes. Evidence: TAS. Frequency: Occasional (HP:0040283). (ORPHA:141184)
- Peripheral arteriovenous fistula (HP:0100784). Evidence: TAS. Frequency: Occasional (HP:0040283). (ORPHA:141184)
- Visceral hemangioma (HP:0410266): A hemangioma arising from within visceral structures, the internal organs of the body. Evidence: TAS. Frequency: Occasional (HP:0040283). (ORPHA:141184)
- Avascular necrosis (HP:0010885): A disease where there is cellular death (necrosis) of bone components due to interruption of the blood supply. Evidence: TAS. Frequency: Very rare (HP:0040284). (ORPHA:141184)
- Hepatic hemangioma (HP:0031207): A congenital vascular malformation in the liver composed of masses of blood vessels that are atypical or irregular in arrangement and size. Evidence: TAS. Frequency: Very rare (HP:0040284). (ORPHA:141184)
- Lipoatrophy (HP:0100578): Localized loss of fat tissue. Evidence: TAS. Frequency: Very rare (HP:0040284). (ORPHA:141184)
Not associated with this disease:
- Tufted angioma (HP:0012329): A vascular tumor of the skin and subcutaneous tissues and characterized by slow angiomatous proliferation. Evidence: TAS. (ORPHA:141184)